Phenotypes associated with the disease MMEP syndrome (OMIM:601349):
- Microcephaly (HP:0000252): Head circumference below 2 standard deviations below the mean for age and gender. Evidence: IEA. (OMIM:601349)
- Cleft palate (HP:0000175): Cleft palate is a developmental defect of the palate resulting from a failure of fusion of the palatine processes and manifesting as a separation of the roof of the mouth (soft and hard palate). Evidence: TAS. (OMIM:601349)
- Microcornea (HP:0000482): A congenital abnormality of the cornea in which the cornea and the anterior segment of the eye are smaller than normal. The horizontal diameter of the cornea does not reach 10 mm even in adulthood. Evidence: IEA. (OMIM:601349)
- Blepharophimosis (HP:0000581): A fixed reduction in the vertical distance between the upper and lower eyelids with short palpebral fissures. Evidence: IEA. (OMIM:601349)
- Short palpebral fissure (HP:0012745): Distance between the medial and lateral canthi is more than 2 SD below the mean for age (objective); or, apparently reduced length of the palpebral fissures. Evidence: TAS. (OMIM:601349)
- Premature skin wrinkling (HP:0100678): The presence of an increased degree of wrinkling (irregular folds and indentations) of the skin as compared with age-related norms. Evidence: IEA. (OMIM:601349)
- Split foot (HP:0001839): A condition in which middle parts of the foot (toes and metatarsals) are missing giving a cleft appearance. The severity is very variable ranging from slightly hypoplastic 3rd toe over absent 2nd or 3rd toes as far as oligo- or monodactyl feet. Evidence: TAS. (OMIM:601349)
- Microphthalmia (HP:0000568): A developmental anomaly characterized by abnormal smallness of one or both eyes. Evidence: IEA. (OMIM:601349)
- Orofacial cleft (HP:0000202): The presence of a cleft (gap, opening, or groove) in the oral cavity, including cleft of the upper lip and/or cleft of the palate. Cleft of the upper lip is visible as a groove or fissure in the lip, most frequently due to a congenital failure of the maxillary and median nasal processes to fuse. Cleft palate is characterized by a grooved depression or fissure in the roof of the mouth, most often resulting from a congenital failure of the palate to fuse properly. Clefts of the lip and palate can occur individually or together. It is preferable to code each defect separately. Evidence: IEA. (OMIM:601349)
- Widely-spaced maxillary central incisors (HP:0001566): Increased distance between the maxillary central permanent incisor tooth. Evidence: IEA. (OMIM:601349)
- Cryptorchidism (HP:0000028): Testis in inguinal canal. That is, absence of one or both testes from the scrotum owing to failure of the testis or testes to descend through the inguinal canal to the scrotum. Evidence: IEA. (OMIM:601349)
- Cleft upper lip (HP:0000204): A gap or groove in the upper lip. This is a congenital defect resulting from nonfusion of tissues of the lip during embryonal development. Evidence: TAS. (OMIM:601349)
- Mandibular prognathia (HP:0000303): Abnormal prominence of the chin related to increased length of the mandible. Evidence: IEA. (OMIM:601349)
- Intellectual disability (HP:0001249): The term intellectual disability or intellectual developmental disorder is used to describe significantly sub-average intellectual and adaptive functioning based on clinical assessment and as measured by individually administered, appropriately normed, standardized and validated tests of intellectual functioning and adaptive behavior, with onset during the developmental period from infancy through adolescence. Evidence: IEA. (OMIM:601349)
- Autosomal dominant inheritance (HP:0000006): A mode of inheritance that is observed for traits related to a gene encoded on one of the autosomes (i.e., the human chromosomes 1-22) in which a trait manifests in heterozygotes. In the context of medical genetics, an autosomal dominant disorder is caused when a single copy of the mutant allele is present. Males and females are affected equally, and can both transmit the disorder with a risk of 50% for each child of inheriting the mutant allele. Evidence: TAS. (OMIM:601349)